- Congenital onset (HP:0003577): A phenotypic abnormality that is present at birth. Evidence: TAS. (OMIM:600060)
- Abnormal vestibular function (HP:0001751): An abnormality of the functioning of the vestibular apparatus. Evidence: TAS. (OMIM:600060)
- Vertigo (HP:0002321): An abnormal sensation of spinning while the body is actually stationary. Evidence: TAS. (OMIM:600060)
- Sensorineural hearing impairment (HP:0000407): A type of hearing impairment in one or both ears related to an abnormal functionality of the cochlear nerve. Evidence: TAS. (OMIM:600060)
- Autosomal recessive inheritance (HP:0000007): A mode of inheritance that is observed for traits related to a gene encoded on one of the autosomes (i.e., the human chromosomes 1-22) in which a trait manifests in individuals with two pathogenic alleles, either homozygotes (two copies of the same mutant allele) or compound heterozygotes (whereby each copy of a gene has a distinct mutant allele). Evidence: TAS. (OMIM:600060)
These phenotypes are associated with the disease autosomal recessive nonsyndromic hearing loss 2 (OMIM:600060).